- Albinism (HP:0001022): An abnormal reduction in the amount of pigmentation (reduced or absent) of skin, hair and eye (iris and retina). Evidence: IEA. (OMIM:606952)
- Hypopigmentation of hair (HP:0005599). Evidence: TAS. (OMIM:606952)
- Nystagmus (HP:0000639): Rhythmic, involuntary oscillations of one or both eyes related to abnormality in fixation, conjugate gaze, or vestibular mechanisms. Evidence: TAS. (OMIM:606952)
- Hypopigmentation of the skin (HP:0001010): A reduction of skin color related to a decrease in melanin production and deposition. Evidence: TAS. (OMIM:606952)
- Photophobia (HP:0000613): Excessive sensitivity to light with the sensation of discomfort or pain in the eyes due to exposure to bright light. Evidence: TAS. (OMIM:606952)
- Autosomal recessive inheritance (HP:0000007): A mode of inheritance that is observed for traits related to a gene encoded on one of the autosomes (i.e., the human chromosomes 1-22) in which a trait manifests in individuals with two pathogenic alleles, either homozygotes (two copies of the same mutant allele) or compound heterozygotes (whereby each copy of a gene has a distinct mutant allele). Evidence: TAS. (OMIM:606952)
- Fundus hypopigmentation (HP:0007894): Generalized or focal reduced pigmentation of the fundus, evaluated in the context of skin and hair color. Fundoscopy may reveal a low level pigment. Evidence: TAS. (OMIM:606952)
- Visual impairment (HP:0000505): Visual impairment (or vision impairment) is vision loss (of a person) to such a degree as to qualify as an additional support need through a significant limitation of visual capability resulting from either disease, trauma, or congenital or degenerative conditions that cannot be corrected by conventional means, such as refractive correction, medication, or surgery. Evidence: TAS. (OMIM:606952)
These phenotypes are associated with the disease oculocutaneous albinism type 1B (OMIM:606952).